Phenotypes associated with the disease mitochondrial complex I deficiency, nuclear type 34 (OMIM:618776):
- Abnormal diffusion weighted cerebral MRI morphology (HP:0032615): A diffusion abnormality observed in diffusion-weighted magnetic resonance imaging (MRI) of the brain. Molecular diffusion refers to the notion that any type of molecule in a fluid (eg, water) is randomly displaced as the molecule is agitated by thermal energy. Restricted diffusion of water appears bright on diffusion-weighted images. Evidence: PCS. (PMID:31866046)
- Hypsarrhythmia (HP:0002521): Hypsarrhythmia is abnormal interictal high amplitude waves and a background of irregular spikes. There is continuous (during wakefulness), high-amplitude (>200 Hz), generalized polymorphic slowing with no organized background and multifocal spikes demonstrated by electroencephalography (EEG). Evidence: PCS. Frequency: 1/3. (PMID:31866046)
- Seizure (HP:0001250): A seizure is an intermittent abnormality of nervous system physiology characterized by a transient occurrence of signs and/or symptoms due to abnormal excessive or synchronous neuronal activity in the brain. Evidence: PCS. (PMID:31866046)
- Infantile onset (HP:0003593): Onset of signs or symptoms of disease between 28 days to one year of life. Evidence: PCS. (PMID:31866046)
- Decreased activity of mitochondrial complex I (HP:0011923): A reduction in the activity of the mitochondrial respiratory chain complex I, which is part of the electron transport chain in mitochondria. Evidence: PCS. (PMID:31866046)
- Infantile spasms (HP:0012469): Infantile spasms represent a subset of "epileptic spasms". Infantile Spasms are epileptic spasms starting in the first year of life (infancy). Evidence: PCS. Frequency: 1/3. (PMID:31866046)
- Autosomal recessive inheritance (HP:0000007): A mode of inheritance that is observed for traits related to a gene encoded on one of the autosomes (i.e., the human chromosomes 1-22) in which a trait manifests in individuals with two pathogenic alleles, either homozygotes (two copies of the same mutant allele) or compound heterozygotes (whereby each copy of a gene has a distinct mutant allele). Evidence: PCS. (PMID:31866046)
- Feeding difficulties in infancy (HP:0008872): Impaired feeding performance of an infant as manifested by difficulties such as weak and ineffective sucking, brief bursts of sucking, and falling asleep during sucking. There may be difficulties with chewing or maintaining attention. Evidence: PCS. (PMID:31866046)
- Optic atrophy (HP:0000648): Atrophy of the optic nerve. Optic atrophy results from the death of the retinal ganglion cell axons that comprise the optic nerve and manifesting as a pale optic nerve on fundoscopy. Evidence: PCS. (PMID:31866046)
- Intrauterine growth retardation (HP:0001511): An abnormal restriction of fetal growth with fetal weight below the tenth percentile for gestational age. Evidence: PCS. Frequency: 1/3. (PMID:31866046)
- Optic disc pallor (HP:0000543): A pale yellow discoloration of the optic disc (the area of the optic nerve head in the retina). The optic disc normally has a pinkish hue with a central yellowish depression. Evidence: PCS. (PMID:31866046)
- Metabolic acidosis (HP:0001942): Metabolic acidosis (MA) is characterized by a fall in blood pH due to a reduction of serum bicarbonate concentration. This can occur as a result of either the accumulation of acids (high anion gap MA) or the loss of bicarbonate from the gastrointestinal tract or the kidney (hyperchloremic MA). By definition, MA is not due to a respirary cause. Evidence: PCS. (PMID:31866046)
- Lactic acidosis (HP:0003128): An abnormal buildup of lactic acid in the body, leading to acidification of the blood and other bodily fluids. Evidence: PCS. Frequency: 3/3. (PMID:31866046)
- Respiratory failure requiring assisted ventilation (HP:0004887): A state of respiratory distress that requires a life saving intervention in the form of gaining airway access and instituting positive pressure ventilation. Evidence: PCS. (PMID:31866046)